Phenotypes associated with the disease hepatitis, fulminant viral, susceptibility to (OMIM:618549):
- Fulminant hepatitis (HP:0004787): Acute hepatitis complicated by acute liver failure with hepatic encephalopathy occurring less than 8 weeks after the onset of jaundice. Evidence: PCS. Frequency: 1/1. (PMID:31213488)
- Hepatic failure (HP:0001399). Evidence: PCS. Frequency: 1/1. (PMID:31213488)
- Poor appetite (HP:0004396): A reduced desire to eat. Evidence: PCS. Frequency: 1/1. (PMID:31213488)
- Hepatomegaly (HP:0002240): Abnormally increased size of the liver. Evidence: PCS. Frequency: 1/1. (PMID:31213488)
- Type I diabetes mellitus (HP:0100651): A chronic condition in which the pancreas produces little or no insulin. Type I diabetes mellitus is manifested by the sudden onset of severe hyperglycemia with rapid progression to diabetic ketoacidosis unless treated with insulin. Evidence: PCS. Frequency: 1/1. (PMID:31213488)
- Fatigue (HP:0012378): A subjective feeling of tiredness characterized by a lack of energy and motivation. Evidence: PCS. Frequency: 1/1. (PMID:31213488)
- Autosomal recessive inheritance (HP:0000007): A mode of inheritance that is observed for traits related to a gene encoded on one of the autosomes (i.e., the human chromosomes 1-22) in which a trait manifests in individuals with two pathogenic alleles, either homozygotes (two copies of the same mutant allele) or compound heterozygotes (whereby each copy of a gene has a distinct mutant allele). Evidence: PCS. (PMID:31213488)
- Nausea (HP:0002018): A sensation of unease in the stomach together with an urge to vomit. Evidence: PCS. Frequency: 1/1. (PMID:31213488)
- Hashimoto thyroiditis (HP:0000872): A chronic, autoimmune type of thyroiditis associated with hypothyroidism. Evidence: PCS. Frequency: 1/1. (PMID:31213488)
- Elevated circulating hepatic transaminase concentration (HP:0002910): Elevations of the levels of SGOT and SGPT in the serum. SGOT (serum glutamic oxaloacetic transaminase) and SGPT (serum glutamic pyruvic transaminase) are transaminases primarily found in the liver and heart and are released into the bloodstream as the result of liver or heart damage. SGOT and SGPT are used clinically mainly as markers of liver damage. Evidence: PCS. Frequency: 1/1. (PMID:31213488)
- Jaundice (HP:0000952): Yellow pigmentation of the skin due to bilirubin, which in turn is the result of increased bilirubin concentration in the bloodstream. Evidence: PCS. Frequency: 1/1. (PMID:31213488)
- Coma (HP:0001259): The complete absence of wakefulness and consciousness, which is evident through a lack of response to any form of external stimuli. Evidence: PCS. Frequency: 1/1. (PMID:31213488)
- Gingival bleeding (HP:0000225): Hemorrhage affecting the gingiva. Evidence: PCS. Frequency: 1/1. (PMID:31213488)